- Progressive hearing impairment (HP:0001730): A progressive form of hearing impairment. Evidence: TAS. (OMIM:606012)
- Autosomal dominant inheritance (HP:0000006): A mode of inheritance that is observed for traits related to a gene encoded on one of the autosomes (i.e., the human chromosomes 1-22) in which a trait manifests in heterozygotes. In the context of medical genetics, an autosomal dominant disorder is caused when a single copy of the mutant allele is present. Males and females are affected equally, and can both transmit the disorder with a risk of 50% for each child of inheriting the mutant allele. Evidence: IEA. (OMIM:606012)
These phenotypes are associated with the disease autosomal dominant nonsyndromic hearing loss 18 (OMIM:606012).